Phenotypes associated with the disease lymphoblastic leukemia, acute, with lymphomatous features (OMIM:247640):
- T-cell acute lymphoblastic leukemias (HP:0006727): Acute lymphoblastic leukemia of T-cell origin. It comprises about 15% of childhood cases and 25% of adult cases. It is more common in males than females. Evidence: TAS. (OMIM:247640)
- Autosomal recessive inheritance (HP:0000007): A mode of inheritance that is observed for traits related to a gene encoded on one of the autosomes (i.e., the human chromosomes 1-22) in which a trait manifests in individuals with two pathogenic alleles, either homozygotes (two copies of the same mutant allele) or compound heterozygotes (whereby each copy of a gene has a distinct mutant allele). Evidence: TAS. (OMIM:247640)
- Acute lymphoblastic leukemia (HP:0006721): A form of acute leukemia characterized by excess lympoblasts. Evidence: TAS. (OMIM:247640)
- Lymphoma (HP:0002665): A cancer originating in lymphocytes and presenting as a solid tumor of lymhpoid cells. Evidence: TAS. (OMIM:247640)